Phenotypes associated with the disease age related macular degeneration 4 (OMIM:610698):
- Macular degeneration (HP:0000608): A nonspecific term denoting degeneration of the retinal pigment epithelium and/or retinal photoreceptor cells of the macula lutea. Evidence: PCS. Onset: Late onset (HP:0003584). (PMID:24906858)
- Adult onset (HP:0003581): Onset of disease manifestations in adulthood, defined here as at the age of 16 years or later. Evidence: PCS. (PMID:24906858)
- Polygenic inheritance (HP:0010982): A mode of inheritance that depends on a mixture of major and minor genetic determinants possibly together with environmental factors. Diseases inherited in this manner are termed complex diseases. Evidence: IEA. (OMIM:610698)
- Autosomal dominant inheritance (HP:0000006): A mode of inheritance that is observed for traits related to a gene encoded on one of the autosomes (i.e., the human chromosomes 1-22) in which a trait manifests in heterozygotes. In the context of medical genetics, an autosomal dominant disorder is caused when a single copy of the mutant allele is present. Males and females are affected equally, and can both transmit the disorder with a risk of 50% for each child of inheriting the mutant allele. Evidence: PCS. (PMID:24906858)